Phenotypes associated with the disease Smith-Magenis syndrome (DECIPHER:8):
- Brachydactyly (HP:0001156): Digits that appear disproportionately short compared to the hand/foot. The word brachydactyly is used here to describe a series distinct patterns of shortened digits (brachydactyly types A-E). This is the sense used here. Evidence: IEA. (DECIPHER:8)
- Short stature (HP:0004322): A height below that which is expected according to age and gender norms. Although there is no universally accepted definition of short stature, many refer to "short stature" as height more than 2 standard deviations below the mean for age and gender (or below the 3rd percentile for age and gender dependent norms). Evidence: IEA. (DECIPHER:8)
- Hoarse voice (HP:0001609): Hoarseness refers to a change in the pitch or quality of the voice, with the voice sounding weak, very breathy, scratchy, or husky. Evidence: IEA. (DECIPHER:8)
- Sleep disturbance (HP:0002360): An abnormal pattern in the quality, quantity, or characteristics of sleep. Evidence: IEA. (DECIPHER:8)
- Hypotonia (HP:0001252): Hypotonia is an abnormally low muscle tone (the amount of tension or resistance to movement in a muscle). Even when relaxed, muscles have a continuous and passive partial contraction which provides some resistance to passive stretching. Hypotonia thus manifests as diminished resistance to passive stretching. Hypotonia is not the same as muscle weakness, although the two conditions can co-exist. Evidence: IEA. (DECIPHER:8)
- Motor stereotypy (HP:0000733): Use of the same abnormal action in response to certain triggers or at random. They may be used as a way to regulate one's internal state but must otherwise have no apparent functional purpose. Evidence: IEA. (DECIPHER:8)
- Hyperactivity (HP:0000752): Hyperactivity is a condition characterized by constant and unusually high levels of activity, even in situations where it is deemed inappropriate. Evidence: IEA. (DECIPHER:8)
- Intellectual disability (HP:0001249): The term intellectual disability or intellectual developmental disorder is used to describe significantly sub-average intellectual and adaptive functioning based on clinical assessment and as measured by individually administered, appropriately normed, standardized and validated tests of intellectual functioning and adaptive behavior, with onset during the developmental period from infancy through adolescence. Evidence: IEA. (DECIPHER:8)
- Self-mutilation (HP:0000742): Deliberate harm to one's body resulting in tissue damage, without a conscious intent to die. Evidence: IEA. (DECIPHER:8)